Phenotypes associated with the disease Methylmalonic acidemia with homocystinuria, type cblD (ORPHA:79283):
- Atypical behavior (HP:0000708): Atypical behavior is an abnormality in a person's actions that can be controlled or modulated by the will of the individual. While abnormal behaviors can be difficult to control, they are distinct from other abnormal actions that cannot be affected by the individual's will. Evidence: TAS. Frequency: Very frequent (HP:0040281). (ORPHA:79283)
- Pallor (HP:0000980): Abnormally pale skin. Evidence: TAS. Frequency: Very frequent (HP:0040281). (ORPHA:79283)
- Intellectual disability (HP:0001249): The term intellectual disability or intellectual developmental disorder is used to describe significantly sub-average intellectual and adaptive functioning based on clinical assessment and as measured by individually administered, appropriately normed, standardized and validated tests of intellectual functioning and adaptive behavior, with onset during the developmental period from infancy through adolescence. Evidence: TAS. Frequency: Very frequent (HP:0040281). (ORPHA:79283)
- Seizure (HP:0001250): A seizure is an intermittent abnormality of nervous system physiology characterized by a transient occurrence of signs and/or symptoms due to abnormal excessive or synchronous neuronal activity in the brain. Evidence: TAS. Frequency: Very frequent (HP:0040281). (ORPHA:79283)
- Lethargy (HP:0001254): A state of fatigue, either physical or mental slowness and sluggishness, with difficulties in initiating or performing simple tasks. Distinguished from apathy which implies indifference and a lack of desire or interest in the task. A person with lethargy may have the desire, but not the energy to engage in personal or socially relevant tasks. Evidence: TAS. Frequency: Very frequent (HP:0040281). (ORPHA:79283)
- Global developmental delay (HP:0001263): A delay in the achievement of motor or mental milestones in the domains of development of a child, including motor skills, speech and language, cognitive skills, and social and emotional skills. This term should only be used to describe children younger than five years of age. Evidence: TAS. Frequency: Very frequent (HP:0040281). (ORPHA:79283)
- Gait disturbance (HP:0001288): The term gait disturbance can refer to any disruption of the ability to walk. Evidence: TAS. Frequency: Very frequent (HP:0040281). (ORPHA:79283)
- Failure to thrive (HP:0001508): Failure to thrive (FTT) refers to a child whose physical growth is substantially below the norm. Evidence: TAS. Frequency: Very frequent (HP:0040281). (ORPHA:79283)
- Megaloblastic bone marrow (HP:0001980): Abnormal increased number of megaloblasts in the bone marrow. Evidence: TAS. Frequency: Very frequent (HP:0040281). (ORPHA:79283)
- Anorexia (HP:0002039): Lack of desire to eat (loss of appetite). Evidence: TAS. Frequency: Very frequent (HP:0040281). (ORPHA:79283)
- Fatigue (HP:0012378): A subjective feeling of tiredness characterized by a lack of energy and motivation. Evidence: TAS. Frequency: Very frequent (HP:0040281). (ORPHA:79283)
- Abnormality of movement (HP:0100022): An abnormality of movement with a neurological basis characterized by changes in coordination and speed of voluntary movements. Evidence: TAS. Frequency: Very frequent (HP:0040281). (ORPHA:79283)